- Congenital onset (HP:0003577): A phenotypic abnormality that is present at birth. Evidence: PCS. Frequency: 1/11. (PMID:30535804)
- Juvenile onset (HP:0003621): Onset of signs or symptoms of disease between the age of 5 and 15 years. Evidence: PCS. Frequency: 1/11. (PMID:30535804)
- Middle age onset (HP:0003596): A type of adult onset with onset of symptoms at the age of 40 to 60 years. Evidence: PCS. Frequency: 1/11. (PMID:30535804)
- Childhood onset (HP:0011463): Onset of disease at the age of between 1 and 5 years. Evidence: IEA. Frequency: 8/11. (PMID:30535804)
- Sensorineural hearing impairment (HP:0000407): A type of hearing impairment in one or both ears related to an abnormal functionality of the cochlear nerve. Evidence: PCS. Frequency: 11/11. (PMID:30535804)
- Tinnitus (HP:0000360): Tinnitus is an auditory perception that can be described as the experience of sound, in the ear or in the head, in the absence of external acoustic stimulation. Evidence: PCS. Frequency: 2/11. (PMID:30535804)
- Autosomal dominant inheritance (HP:0000006): A mode of inheritance that is observed for traits related to a gene encoded on one of the autosomes (i.e., the human chromosomes 1-22) in which a trait manifests in heterozygotes. In the context of medical genetics, an autosomal dominant disorder is caused when a single copy of the mutant allele is present. Males and females are affected equally, and can both transmit the disorder with a risk of 50% for each child of inheriting the mutant allele. Evidence: PCS. (PMID:30535804)
These phenotypes are associated with the disease hearing loss, autosomal dominant 82 (OMIM:619804).